- Thin upper lip vermilion (HP:0000219): Height of the vermilion of the upper lip in the midline more than 2 SD below the mean. Alternatively, an apparently reduced height of the vermilion of the upper lip in the frontal view (subjective). Evidence: TAS. Frequency: Very frequent (HP:0040281). (ORPHA:352530)
- Brachycephaly (HP:0000248): An abnormality of skull shape characterized by a decreased anterior-posterior diameter. That is, a cephalic index greater than 81%. Alternatively, an apparently shortened anteroposterior dimension (length) of the head compared to width. Evidence: TAS. Frequency: Very frequent (HP:0040281). (ORPHA:352530)
- Microcephaly (HP:0000252): Head circumference below 2 standard deviations below the mean for age and gender. Evidence: TAS. Frequency: Very frequent (HP:0040281). (ORPHA:352530)
- Epicanthus (HP:0000286): A fold of skin starting above the medial aspect of the upper eyelid and arching downward to cover, pass in front of and lateral to the medial canthus. Evidence: TAS. Frequency: Frequent (HP:0040282). (ORPHA:352530)
- Round face (HP:0000311): The facial appearance is more circular than usual as viewed from the front. Evidence: TAS. Frequency: Very frequent (HP:0040281). (ORPHA:352530)
- Hypertelorism (HP:0000316): Interpupillary distance more than 2 SD above the mean (alternatively, the appearance of an increased interpupillary distance or widely spaced eyes). Evidence: TAS. Frequency: Very frequent (HP:0040281). (ORPHA:352530)
- Narrow forehead (HP:0000341): Width of the forehead or distance between the frontotemporales is more than two standard deviations below the mean (objective); or apparently narrow intertemporal region (subjective). Evidence: TAS. Frequency: Very frequent (HP:0040281). (ORPHA:352530)
- Abnormal pinna morphology (HP:0000377): An abnormality of the pinna, which is also referred to as the auricle or external ear. Evidence: TAS. Frequency: Frequent (HP:0040282). (ORPHA:352530)
- Wide nasal bridge (HP:0000431): Increased breadth of the nasal bridge (and with it, the nasal root). Evidence: TAS. Frequency: Very frequent (HP:0040281). (ORPHA:352530)
- Synophrys (HP:0000664): Meeting of the medial eyebrows in the midline. Evidence: TAS. Frequency: Very frequent (HP:0040281). (ORPHA:352530)
- Global developmental delay (HP:0001263): A delay in the achievement of motor or mental milestones in the domains of development of a child, including motor skills, speech and language, cognitive skills, and social and emotional skills. This term should only be used to describe children younger than five years of age. Evidence: TAS. Frequency: Very frequent (HP:0040281). (ORPHA:352530)
- Congenital hypothyroidism (HP:0000851): A type of hypothyroidism with congenital onset. Evidence: TAS. Frequency: Very frequent (HP:0040281). (ORPHA:352530)
- Tapered finger (HP:0001182): The gradual reduction in girth of the finger from proximal to distal. Evidence: TAS. Frequency: Very frequent (HP:0040281). (ORPHA:352530)
- Seizure (HP:0001250): A seizure is an intermittent abnormality of nervous system physiology characterized by a transient occurrence of signs and/or symptoms due to abnormal excessive or synchronous neuronal activity in the brain. Evidence: TAS. Frequency: Frequent (HP:0040282). (ORPHA:352530)
- Hypotonia (HP:0001252): Hypotonia is an abnormally low muscle tone (the amount of tension or resistance to movement in a muscle). Even when relaxed, muscles have a continuous and passive partial contraction which provides some resistance to passive stretching. Hypotonia thus manifests as diminished resistance to passive stretching. Hypotonia is not the same as muscle weakness, although the two conditions can co-exist. Evidence: TAS. Frequency: Very frequent (HP:0040281). (ORPHA:352530)
- Cerebellar hypoplasia (HP:0001321): Cerebellar hypoplasia is a descriptive term implying a cerebellum with a reduced volume, but a normal shape and is stable over time. Evidence: TAS. Frequency: Very frequent (HP:0040281). (ORPHA:352530)
- Obesity (HP:0001513): Accumulation of substantial excess body fat. Evidence: TAS. Frequency: Very frequent (HP:0040281). (ORPHA:352530)
- Abnormal facial shape (HP:0001999): An abnormal morphology (form) of the face or its components. Evidence: TAS. Frequency: Very frequent (HP:0040281). (ORPHA:352530)
- Malignant hyperthermia (HP:0002047): Malignant hyperthermia is characterized by a rapid increase in temperature to 39-42 degrees C. Malignant hyperthermia may occur in response to either inhalational anesthetics such as halothane, to muscle relaxants such as succinylcholine, or to exercise. Evidence: TAS. Frequency: Very frequent (HP:0040281). (ORPHA:352530)
- Hypoplasia of the corpus callosum (HP:0002079): Underdevelopment of the corpus callosum. Evidence: TAS. Frequency: Very frequent (HP:0040281). (ORPHA:352530)
- Cerebral cortical atrophy (HP:0002120): Atrophy of the cortex of the cerebrum. Evidence: TAS. Frequency: Very frequent (HP:0040281). (ORPHA:352530)
- Generalized myoclonic seizure (HP:0002123): A generalized myoclonic seizure is a type of generalized motor seizure characterized by bilateral, sudden, brief (<100 ms) involuntary single or multiple contraction of muscles or muscle groups of variable topography (axial, proximal limb, distal). Myoclonus is less regularly repetitive and less sustained than is clonus. Evidence: TAS. Frequency: Frequent (HP:0040282). (ORPHA:352530)
- Large fleshy ears (HP:0002265). Evidence: TAS. Frequency: Very frequent (HP:0040281). (ORPHA:352530)
- Downturned corners of mouth (HP:0002714): A morphological abnormality of the mouth in which the angle of the mouth is downturned. The oral commissures are positioned inferior to the midline labial fissure. Evidence: TAS. Frequency: Very frequent (HP:0040281). (ORPHA:352530)
- Clinodactyly of the 5th finger (HP:0004209): Clinodactyly refers to a bending or curvature of the fifth finger in the radial direction (i.e., towards the 4th finger). Evidence: TAS. Frequency: Very frequent (HP:0040281). (ORPHA:352530)
- Underdeveloped supraorbital ridges (HP:0009891): Flatness of the supraorbital portion of the frontal bones. Evidence: TAS. Frequency: Very frequent (HP:0040281). (ORPHA:352530)
- Multifocal cerebral white matter abnormalities (HP:0007052). Evidence: TAS. Frequency: Very frequent (HP:0040281). (ORPHA:352530)
- Severe intellectual disability (HP:0010864): Severe intellectual disability (ID) is defined as a type of ID characterized by severely sub-average adaptive functioning and intellectual functioning, with an intelligence quotient (IQ) the range of 20-34. Evidence: TAS. Frequency: Very frequent (HP:0040281). (ORPHA:352530)
- Early-onset non-progressive night blindness (HP:0007642): A usually nonprogressive (i.e., stationary) form of night blindness with early (presumed to be congenital) onset. Evidence: TAS. Frequency: Very frequent (HP:0040281). (ORPHA:352530)
- Horizontal eyebrow (HP:0011228): An eyebrow that extends straight across the brow, without curve. Evidence: TAS. Frequency: Frequent (HP:0040282). (ORPHA:352530)
- Abnormal brain morphology (HP:0012443): A structural abnormality of the brain, which has as its parts the forebrain, midbrain, and hindbrain. Evidence: TAS. Frequency: Very frequent (HP:0040281). (ORPHA:352530)
These phenotypes are associated with the disease Intellectual disability-obesity-brain malformations-facial dysmorphism syndrome (ORPHA:352530).